- Rod-cone dystrophy (HP:0000510): An inherited retinal disease subtype in which the rod photoreceptors appear to be more severely affected than the cone photoreceptors. Typical presentation is with nyctalopia (due to rod dysfunction) followed by loss of mid-peripheral field of vision, which gradually extends and leaves many patients with a small central island of vision due to the preservation of macular cones. Evidence: TAS. (OMIM:400004)
This phenotype is associated with the disease retinitis pigmentosa Y-linked (OMIM:400004).